- Kyphoscoliosis (HP:0002751): An abnormal curvature of the spine in both a coronal (lateral) and sagittal (back-to-front) plane. Evidence: IEA. (OMIM:260540)
- Parkinsonism (HP:0001300): Characteristic neurologic anomaly resulting from degeneration of dopamine-generating cells in the substantia nigra, a region of the midbrain, characterized clinically by shaking, rigidity, slowness of movement and difficulty with walking and gait. Evidence: IEA. (OMIM:260540)
- Dementia (HP:0000726): A loss of global cognitive ability of sufficient amount to interfere with normal social or occupational function. Dementia represents a loss of previously present cognitive abilities, generally in adults, and can affect memory, thinking, language, judgment, and behavior. Evidence: IEA. (OMIM:260540)
- Rigidity (HP:0002063): Continuous involuntary sustained muscle contraction. When an affected muscle is passively stretched, the degree of resistance remains constant regardless of the rate at which the muscle is stretched. This feature helps to distinguish rigidity from muscle spasticity. Evidence: IEA. (OMIM:260540)
- Adult onset (HP:0003581): Onset of disease manifestations in adulthood, defined here as at the age of 16 years or later. Evidence: IEA. (OMIM:260540)
- Young adult onset (HP:0011462): Onset of disease at the age of between 16 and 40 years. Evidence: TAS. (OMIM:260540)
- Abnormal pyramidal tract morphology (HP:0002062): Any structural abnormality of the pyramidal tract, whose chief element, the corticospinal tract, is the only direct connection between the brain and the spinal cord. In addition to the corticospinal tract, the pyramidal system includes the corticobulbar, corticomesencephalic, and corticopontine tracts. Evidence: IEA. (OMIM:260540)
- Abnormal pyramidal sign (HP:0007256): Functional neurological abnormalities related to dysfunction of the pyramidal tract. Evidence: TAS. (OMIM:260540)
- Autosomal recessive inheritance (HP:0000007): A mode of inheritance that is observed for traits related to a gene encoded on one of the autosomes (i.e., the human chromosomes 1-22) in which a trait manifests in individuals with two pathogenic alleles, either homozygotes (two copies of the same mutant allele) or compound heterozygotes (whereby each copy of a gene has a distinct mutant allele). Evidence: TAS. (OMIM:260540)
- Ophthalmoparesis (HP:0000597): Ophthalmoplegia is a paralysis or weakness of one or more of the muscles that control eye movement. Evidence: IEA. (OMIM:260540)
- Tremor (HP:0001337): An unintentional, oscillating to-and-fro muscle movement about a joint axis. Evidence: IEA. (OMIM:260540)
These phenotypes are associated with the disease progressive supranuclear palsy-parkinsonism syndrome (OMIM:260540).